Phenotypes associated with the disease neurodevelopmental disorder with impaired speech and hyperkinetic movements (OMIM:618425):
- Bilateral tonic-clonic seizure (HP:0002069): A bilateral tonic-clonic seizure is a seizure defined by a tonic (bilateral increased tone, lasting seconds to minutes) and then a clonic (bilateral sustained rhythmic jerking) phase. Evidence: PCS. Frequency: 5/7. (PMID:31036918)
- Hyperkinetic movements (HP:0002487): Motor hyperactivity with excessive movement of muscles of the body as a whole. Evidence: PCS. (PMID:31036918)
- Torticollis (HP:0000473): Involuntary contractions of the neck musculature resulting in an abnormal posture of or abnormal movements of the head. Evidence: PCS. Frequency: 3/7. (PMID:31036918)
- Axial hypotonia (HP:0008936): Muscular hypotonia (abnormally low muscle tone) affecting the musculature of the trunk. Evidence: PCS. Frequency: 1/7. (PMID:31036918)
- Delayed speech and language development (HP:0000750): A degree of language development that is significantly below the norm for a child of a specified age. Evidence: PCS. Frequency: 7/7. (PMID:31036918)
- Dystonia (HP:0001332): An abnormally increased muscular tone that causes fixed abnormal postures. There is a slow, intermittent twisting motion that leads to exaggerated turning and posture of the extremities and trunk. Evidence: PCS. Frequency: 3/7. (PMID:31036918)
- Lower limb hyperreflexia (HP:0002395): Increased intensity of the a reflex in the leg. Evidence: PCS. Frequency: 1/7. (PMID:31036918)
- Global developmental delay (HP:0001263): A delay in the achievement of motor or mental milestones in the domains of development of a child, including motor skills, speech and language, cognitive skills, and social and emotional skills. This term should only be used to describe children younger than five years of age. Evidence: PCS. Frequency: 7/7. (PMID:31036918)
- Ataxia (HP:0001251): Ataxia refers to impaired coordination of voluntary muscle movement. Cerebellar ataxia refers to ataxia due to dysfunction of the cerebellum. This causes a variety of elementary neurological deficits including asynergy (lack of coordination between muscles, limbs and joints), dysmetria (lack of ability to judge distances that can lead to under- or overshoot in grasping movements), and dysdiadochokinesia (inability to perform rapid movements requiring antagonizing muscle groups to be switched on and off repeatedly). Evidence: PCS. Frequency: 4/7. (PMID:31036918)
- Infantile onset (HP:0003593): Onset of signs or symptoms of disease between 28 days to one year of life. Evidence: PCS. Frequency: 5/7. (PMID:31036918)
- Chorea (HP:0002072): Chorea (Greek for 'dance') refers to widespread arrhythmic involuntary movements of a forcible, jerky and restless fashion. It is a random-appearing sequence of one or more discrete involuntary movements or movement fragments. Movements appear random because of variability in timing, duration or location. Each movement may have a distinct start and end. However, movements may be strung together and thus may appear to flow randomly from one muscle group to another. Chorea can involve the trunk, neck, face, tongue, and extremities. Evidence: PCS. Frequency: 1/7. (PMID:31036918)
- Autosomal recessive inheritance (HP:0000007): A mode of inheritance that is observed for traits related to a gene encoded on one of the autosomes (i.e., the human chromosomes 1-22) in which a trait manifests in individuals with two pathogenic alleles, either homozygotes (two copies of the same mutant allele) or compound heterozygotes (whereby each copy of a gene has a distinct mutant allele). Evidence: PCS. (PMID:31036918)
- Delayed ability to sit (HP:0025336): A failure to achieve the ability to sit at an appropriate developmental stage. Most children sit with support at 6 months of age and sit steadily without support at 9 months of age. Evidence: PCS. Frequency: 1/7. (PMID:31036918)
- Dolichocephaly (HP:0000268): An abnormality of skull shape characterized by a increased anterior-posterior diameter, i.e., an increased antero-posterior dimension of the skull. Cephalic index less than 76%. Alternatively, an apparently increased antero-posterior length of the head compared to width. Often due to premature closure of the sagittal suture. Evidence: PCS. Frequency: 4/7. (PMID:31036918)
- Tremor (HP:0001337): An unintentional, oscillating to-and-fro muscle movement about a joint axis. Evidence: PCS. Frequency: 4/7. (PMID:31036918)
- Intellectual disability (HP:0001249): The term intellectual disability or intellectual developmental disorder is used to describe significantly sub-average intellectual and adaptive functioning based on clinical assessment and as measured by individually administered, appropriately normed, standardized and validated tests of intellectual functioning and adaptive behavior, with onset during the developmental period from infancy through adolescence. Evidence: PCS. Frequency: 6/7. (PMID:31036918)
- Neonatal onset (HP:0003623): Onset of signs or symptoms of disease within the first 28 days of life. Evidence: PCS. Frequency: 2/7. (PMID:31036918)